Phenotypes associated with the disease Holmes-Adie syndrome (ORPHA:454718):
- Tonic pupil (HP:0012074): An abnormality of the pupillary light reaction characterized by a marked slowing of the light reaction of usually just one pupil. The pupil tends to be relatively dilated, and there is reduced accommodation. Evidence: TAS. Frequency: Very frequent (HP:0040281). (ORPHA:454718)
- Blurred vision (HP:0000622): Lack of sharpness of vision resulting in the inability to see fine detail. Evidence: TAS. Frequency: Frequent (HP:0040282). (ORPHA:454718)
- Areflexia (HP:0001284): Absence of neurologic reflexes such as the knee-jerk reaction. Evidence: TAS. Frequency: Frequent (HP:0040282). (ORPHA:454718)
- Abnormal pupillary light reflex (HP:0007695): An abnormality of the reflex that controls the diameter of the pupil, in response to the intensity of light that falls on the retina of the eye. Evidence: TAS. Frequency: Frequent (HP:0040282). (ORPHA:454718)
- Anisocoria (HP:0009916): Anisocoria, or unequal pupil size, may represent a benign physiologic variant or a manifestation of disease. Evidence: TAS. Frequency: Frequent (HP:0040282). (ORPHA:454718)
- Mydriasis (HP:0011499): Abnormal dilatation of the iris. Evidence: TAS. Frequency: Frequent (HP:0040282). (ORPHA:454718)
- Hypermetropia (HP:0000540): An abnormality of refraction characterized by the ability to see objects in the distance clearly, while objects nearby appear blurry. Evidence: TAS. Frequency: Occasional (HP:0040283). (ORPHA:454718)
- Photophobia (HP:0000613): Excessive sensitivity to light with the sensation of discomfort or pain in the eyes due to exposure to bright light. Evidence: TAS. Frequency: Occasional (HP:0040283). (ORPHA:454718)
- Orthostatic hypotension (HP:0001278): A form of hypotension characterized by a sudden fall in blood pressure that occurs when a person assumes a standing position. Evidence: TAS. Frequency: Occasional (HP:0040283). (ORPHA:454718)
- Anisometropia (HP:0012803): Inequality of refractive power of the two eyes. Evidence: TAS. Frequency: Occasional (HP:0040283). (ORPHA:454718)
- Chronic cough (HP:0034315): A persistent cough, defined as a cough lasting longer than eight weeks in adults or longer than four weeks in children. Evidence: TAS. Frequency: Occasional (HP:0040283). (ORPHA:454718)